Phenotypes associated with the disease rippling muscle disease 1 (OMIM:600332):
- Percussion-induced rapid rolling muscle contractions (HP:0003760): Mechanical percussion (i.e., striking a muscle with a reflex hammer) leads to spreading waves of muscle contractions that begin proximally and spread laterally across the muscle. Evidence: IEA. (OMIM:600332)
- Muscle mounding (HP:0003719): Percussion-induced, local prolonged contractions (mounding) in muscle persisting for several seconds. Evidence: IEA. (OMIM:600332)
- Exercise-induced myalgia (HP:0003738): The occurrence of an unusually high amount of muscle pain following exercise. Evidence: IEA. (OMIM:600332)
- Skeletal muscle hypertrophy (HP:0003712): Abnormal increase in muscle size and mass not due to training. Evidence: IEA. (OMIM:600332)
- Muscle hyperirritability (HP:0003559). Evidence: IEA. (OMIM:600332)
- Autosomal dominant inheritance (HP:0000006): A mode of inheritance that is observed for traits related to a gene encoded on one of the autosomes (i.e., the human chromosomes 1-22) in which a trait manifests in heterozygotes. In the context of medical genetics, an autosomal dominant disorder is caused when a single copy of the mutant allele is present. Males and females are affected equally, and can both transmit the disorder with a risk of 50% for each child of inheriting the mutant allele. Evidence: IEA. (OMIM:600332)
- EMG abnormality (HP:0003457): Abnormal results of investigations using electromyography (EMG). Evidence: IEA. (OMIM:600332)
- Exercise-induced muscle cramps (HP:0003710): Sudden and involuntary contractions of one or more muscles brought on by physical exertion. Evidence: IEA. (OMIM:600332)
- Exercise-induced muscle stiffness (HP:0008967): A type of muscle stiffness that occurs following physical exertion. Evidence: IEA. (OMIM:600332)